Phenotypes associated with the disease nystagmus, congenital, autosomal recessive (OMIM:257400):
- Congenital nystagmus (HP:0006934): Nystagmus dating from or present at birth. Evidence: TAS. (OMIM:257400)
- Nystagmus (HP:0000639): Rhythmic, involuntary oscillations of one or both eyes related to abnormality in fixation, conjugate gaze, or vestibular mechanisms. Evidence: TAS. (OMIM:257400)
- Autosomal recessive inheritance (HP:0000007): A mode of inheritance that is observed for traits related to a gene encoded on one of the autosomes (i.e., the human chromosomes 1-22) in which a trait manifests in individuals with two pathogenic alleles, either homozygotes (two copies of the same mutant allele) or compound heterozygotes (whereby each copy of a gene has a distinct mutant allele). Evidence: IEA. (OMIM:257400)